Phenotypes associated with the disease intellectual disability, autosomal dominant 46 (OMIM:617601):
- Absent speech (HP:0001344): Complete lack of development of speech and language abilities. Evidence: PCS. Frequency: 2/4. (PMID:28669405)
- Delayed speech and language development (HP:0000750): A degree of language development that is significantly below the norm for a child of a specified age. Evidence: PCS. Frequency: 4/4. (PMID:28669405)
- Seizure (HP:0001250): A seizure is an intermittent abnormality of nervous system physiology characterized by a transient occurrence of signs and/or symptoms due to abnormal excessive or synchronous neuronal activity in the brain. Evidence: PCS. Frequency: 2/4. (PMID:28669405)
- Focal impaired awareness seizure (HP:0002384): Focal impaired awareness seizure (or focal seizure with impaired or lost awareness) is a type of focal-onset seizure characterized by some degree (which may be partial) of impairment of the person's awareness of themselves or their surroundings at any point during the seizure. Evidence: PCS. Frequency: 1/4. (PMID:28669405)
- Global developmental delay (HP:0001263): A delay in the achievement of motor or mental milestones in the domains of development of a child, including motor skills, speech and language, cognitive skills, and social and emotional skills. This term should only be used to describe children younger than five years of age. Evidence: PCS. (PMID:28669405)
- Hypotonia (HP:0001252): Hypotonia is an abnormally low muscle tone (the amount of tension or resistance to movement in a muscle). Even when relaxed, muscles have a continuous and passive partial contraction which provides some resistance to passive stretching. Hypotonia thus manifests as diminished resistance to passive stretching. Hypotonia is not the same as muscle weakness, although the two conditions can co-exist. Evidence: PCS. Frequency: 4/4. (PMID:28669405)
- Infantile onset (HP:0003593): Onset of signs or symptoms of disease between 28 days to one year of life. Evidence: PCS. Frequency: 1/2. (PMID:28669405)
- Tube feeding (HP:0033454): Feeding problem necessitating food and nutrient delivery via a tube. Evidence: PCS. Frequency: 1/4. (PMID:28669405)
- Brain atrophy (HP:0012444): Partial or complete wasting (loss) of brain tissue that was once present. Evidence: PCS. Frequency: 1/4. (PMID:28669405)
- Infantile spasms (HP:0012469): Infantile spasms represent a subset of "epileptic spasms". Infantile Spasms are epileptic spasms starting in the first year of life (infancy). Evidence: PCS. Frequency: 1/4. (PMID:28669405)
- Childhood onset (HP:0011463): Onset of disease at the age of between 1 and 5 years. Evidence: PCS. Frequency: 1/2. (PMID:28669405)
- Tonic seizure (HP:0032792): A tonic seizure is a type of motor seizure characterized by unilateral or bilateral limb stiffening or elevation, often with neck stiffening. Evidence: PCS. Frequency: 1/4. (PMID:28669405)
- Epileptic encephalopathy (HP:0200134): A condition in which epileptiform abnormalities are believed to contribute to the progressive disturbance in cerebral function. Epileptic encephalaopathy is characterized by (1) electrographic EEG paroxysmal activity that is often aggressive, (2) seizures that are usually multiform and intractable, (3) cognitive, behavioral and neurological deficits that may be relentless, and (4) sometimes early death. Evidence: PCS. Frequency: 1/4. (PMID:28669405)
- Unsteady gait (HP:0002317). Evidence: PCS. Frequency: 2/4. (PMID:28669405)
- Fetal distress (HP:0025116): An intrauterine state characterized by suboptimal values in the fetal heart rate, oxygenation of fetal blood, or other parameters indicative of compromise of the fetus. Signs of fetal distress include repetitive variable decelerations, fetal tachycardia or bradycardia, late decelerations, or low biophysical profile. Evidence: PCS. Frequency: 1/4. (PMID:28669405)
- Intellectual disability (HP:0001249): The term intellectual disability or intellectual developmental disorder is used to describe significantly sub-average intellectual and adaptive functioning based on clinical assessment and as measured by individually administered, appropriately normed, standardized and validated tests of intellectual functioning and adaptive behavior, with onset during the developmental period from infancy through adolescence. Evidence: PCS. Frequency: 4/4. (PMID:28669405)
- Autosomal dominant inheritance (HP:0000006): A mode of inheritance that is observed for traits related to a gene encoded on one of the autosomes (i.e., the human chromosomes 1-22) in which a trait manifests in heterozygotes. In the context of medical genetics, an autosomal dominant disorder is caused when a single copy of the mutant allele is present. Males and females are affected equally, and can both transmit the disorder with a risk of 50% for each child of inheriting the mutant allele. Evidence: PCS. (PMID:28669405)